Phenotypes associated with the disease Immune suppression (OMIM:146850):
- Abnormality of the immune system (HP:0002715): An abnormality of the immune system. Evidence: IEA. (OMIM:146850)
- Autosomal dominant inheritance (HP:0000006): A mode of inheritance that is observed for traits related to a gene encoded on one of the autosomes (i.e., the human chromosomes 1-22) in which a trait manifests in heterozygotes. In the context of medical genetics, an autosomal dominant disorder is caused when a single copy of the mutant allele is present. Males and females are affected equally, and can both transmit the disorder with a risk of 50% for each child of inheriting the mutant allele. Evidence: IEA. (OMIM:146850)